- Short nail (HP:0001799): Decreased length of nail. Evidence: TAS. Frequency: Very frequent (HP:0040281). (ORPHA:973)
- Abnormal metacarpal morphology (HP:0005916): Any abnormal shape or structure of the metacarpal bones. Evidence: TAS. Frequency: Very frequent (HP:0040281). (ORPHA:973)
- Short thumb (HP:0009778): Hypoplasia (congenital reduction in size) of the thumb. Evidence: TAS. Frequency: Very frequent (HP:0040281). (ORPHA:973)
- Duplication of the distal phalanx of the 5th finger (HP:0009988): Partial or complete duplication of the distal phalanx of little finger. Evidence: TAS. Frequency: Very frequent (HP:0040281). (ORPHA:973)
- Short metacarpal (HP:0010049): Diminished length of one or more metacarpal bones in relation to the others of the same hand or to the contralateral metacarpal. Evidence: TAS. Frequency: Very frequent (HP:0040281). (ORPHA:973)
These phenotypes are associated with the disease Isolated absence/hypoplasia of fingers excluding thumb, unilateral (ORPHA:973).